Phenotypes associated with the disease Ramos-Arroyo syndrome (OMIM:122430):
- Abnormal hair morphology (HP:0001595): An abnormality of the hair. Evidence: IEA. (OMIM:122430)
- Upslanted palpebral fissure (HP:0000582): The palpebral fissure inclination is more than two standard deviations above the mean for age (objective); or, the inclination of the palpebral fissure is greater than typical for age. Evidence: IEA. (OMIM:122430)
- Anteverted nares (HP:0000463): Anteriorly-facing nostrils viewed with the head in the Frankfurt horizontal and the eyes of the observer level with the eyes of the subject. This gives the appearance of an upturned nose (upturned nasal tip). Evidence: IEA. (OMIM:122430)
- Short stature (HP:0004322): A height below that which is expected according to age and gender norms. Although there is no universally accepted definition of short stature, many refer to "short stature" as height more than 2 standard deviations below the mean for age and gender (or below the 3rd percentile for age and gender dependent norms). Evidence: IEA. (OMIM:122430)
- Keratitis (HP:0000491): Inflammation of the cornea. Evidence: IEA. (OMIM:122430)
- Malar flattening (HP:0000272): Underdevelopment of the malar prominence of the jugal bone (zygomatic bone in mammals), appreciated in profile, frontal view, and/or by palpation. Evidence: IEA. (OMIM:122430)
- Midface retrusion (HP:0011800): Posterior positions and/or vertical shortening of the infraorbital and perialar regions, or increased concavity of the face and/or reduced nasolabial angle. Evidence: TAS. (OMIM:122430)
- Depressed nasal bridge (HP:0005280): Posterior positioning of the nasal root in relation to the overall facial profile for age. Evidence: IEA. (OMIM:122430)
- Broad eyebrow (HP:0011229): Regional increase in the width (height) of the eyebrow. Evidence: TAS. (OMIM:122430)
- Decreased corneal sensation (HP:0012155): Reduced ability of the cornea to respond to stimulation. Evidence: IEA. (OMIM:122430)
- Failure to thrive (HP:0001508): Failure to thrive (FTT) refers to a child whose physical growth is substantially below the norm. Evidence: IEA. (OMIM:122430)
- Sensorineural hearing impairment (HP:0000407): A type of hearing impairment in one or both ears related to an abnormal functionality of the cochlear nerve. Evidence: IEA. (OMIM:122430)
- Absent retinal pigment epithelium (HP:0007980): Discrete areas of pallor in which the pigment epithelium, choriocapillaris and choroidal pigment are absent. Evidence: IEA. (OMIM:122430)
- Hypertelorism (HP:0000316): Interpupillary distance more than 2 SD above the mean (alternatively, the appearance of an increased interpupillary distance or widely spaced eyes). Evidence: IEA. (OMIM:122430)
- Reduced visual acuity (HP:0007663). Evidence: TAS. (OMIM:122430)
- Visual impairment (HP:0000505): Visual impairment (or vision impairment) is vision loss (of a person) to such a degree as to qualify as an additional support need through a significant limitation of visual capability resulting from either disease, trauma, or congenital or degenerative conditions that cannot be corrected by conventional means, such as refractive correction, medication, or surgery. Evidence: IEA. (OMIM:122430)
- Patent ductus arteriosus (HP:0001643): In utero, the ductus arteriosus (DA) serves to divert ventricular output away from the lungs and toward the placenta by connecting the main pulmonary artery to the descending aorta. A patent ductus arteriosus (PDA) in the first 3 days of life is a physiologic shunt in healthy term and preterm newborn infants, and normally is substantially closed within about 24 hours after bith and completely closed after about three weeks. Failure of physiologcal closure is referred to a persistent or patent ductus arteriosus (PDA). Depending on the degree of left-to-right shunting, PDA can have clinical consequences. Evidence: IEA. (OMIM:122430)
- Frontal bossing (HP:0002007): Bilateral bulging of the lateral frontal bone prominences with relative sparing of the midline. Evidence: IEA. (OMIM:122430)
- Autosomal dominant inheritance (HP:0000006): A mode of inheritance that is observed for traits related to a gene encoded on one of the autosomes (i.e., the human chromosomes 1-22) in which a trait manifests in heterozygotes. In the context of medical genetics, an autosomal dominant disorder is caused when a single copy of the mutant allele is present. Males and females are affected equally, and can both transmit the disorder with a risk of 50% for each child of inheriting the mutant allele. Evidence: IEA. (OMIM:122430)
- Low-set ears (HP:0000369): Upper insertion of the ear to the scalp below an imaginary horizontal line drawn between the inner canthi of the eye and extending posteriorly to the ear. Evidence: IEA. (OMIM:122430)
- Intellectual disability (HP:0001249): The term intellectual disability or intellectual developmental disorder is used to describe significantly sub-average intellectual and adaptive functioning based on clinical assessment and as measured by individually administered, appropriately normed, standardized and validated tests of intellectual functioning and adaptive behavior, with onset during the developmental period from infancy through adolescence. Evidence: IEA. (OMIM:122430)